Phenotypes associated with the disease hypertrophic cardiomyopathy 7 (OMIM:613690):
- Wolff-Parkinson-White syndrome (HP:0001716): A disorder of the cardiac conduction system of the heart characterized by ventricular preexcitation due to the presence of an abnormal accessory atrioventricular electrical conduction pathway. Evidence: PCS. Frequency: 3/6. (PMID:9241277)
- Hypertrophic cardiomyopathy (HP:0001639): Hypertrophic cardiomyopathy (HCM) is defined by the presence of increased ventricular wall thickness or mass in the absence of loading conditions (hypertension, valve disease) sufficient to cause the observed abnormality. Evidence: PCS. Frequency: 2/2. (PMID:11815426)
- Adult onset (HP:0003581): Onset of disease manifestations in adulthood, defined here as at the age of 16 years or later. Evidence: IEA. Frequency: 6/6. (PMID:11815426)
- Atrial fibrillation (HP:0005110): An atrial arrhythmia characterized by disorganized atrial activity without discrete P waves on the surface EKG, but instead by an undulating baseline or more sharply circumscribed atrial deflections of varying amplitude an frequency ranging from 350 to 600 per minute. Evidence: TAS. Frequency: Occasional (HP:0040283). (OMIM:613690)
- Apical hypertrophic cardiomyopathy (HP:0031992): Apical hypertrophic cardiomyopathy (AHCM) is diastolic dysfunction due to abnormal stiffness of the left ventricle during diastole, with resultant impaired ventricular filling. In AHCM thickened apical segments produce a crowded, spade-shaped, small apical cavity. Evidence: PCS. Frequency: 3/6. (PMID:9241277)
- Ventricular hypertrophy (HP:0001714): Enlargement of the cardiac ventricular muscle tissue with increase in the width of the wall of the ventricle and loss of elasticity. Ventricular hypertrophy is clinically differentiated into left and right ventricular hypertrophy. Evidence: TAS. (OMIM:613690)
- Autosomal dominant inheritance (HP:0000006): A mode of inheritance that is observed for traits related to a gene encoded on one of the autosomes (i.e., the human chromosomes 1-22) in which a trait manifests in heterozygotes. In the context of medical genetics, an autosomal dominant disorder is caused when a single copy of the mutant allele is present. Males and females are affected equally, and can both transmit the disorder with a risk of 50% for each child of inheriting the mutant allele. Evidence: PCS. (PMID:9241277)